Phenotypes associated with the disease nephrotic syndrome, type 12 (OMIM:616892):
- Stage 5 chronic kidney disease (HP:0003774): A degree of kidney failure severe enough to require dialysis or kidney transplantation for survival characterized by a severe reduction in glomerular filtration rate (less than 15 ml/min/1.73 m2) and other manifestations including increased serum creatinine. Evidence: TAS. (OMIM:616892)
- Progressive (HP:0003676): Applies to a disease manifestation that increases in scope or severity over the course of time, i.e., that worsens with age. Evidence: TAS. (OMIM:616892)
- Focal segmental glomerulosclerosis (HP:0000097): Segmental accumulation of scar tissue in individual (but not all) glomeruli. Evidence: PCS. Frequency: 5/5. (OMIM:616892)
- Hematuria (HP:0000790): The presence of blood in the urine. Hematuria may be gross hematuria (visible to the naked eye) or microscopic hematuria (detected by dipstick or microscopic examination of the urine). Evidence: TAS. (OMIM:616892)
- Autosomal recessive inheritance (HP:0000007): A mode of inheritance that is observed for traits related to a gene encoded on one of the autosomes (i.e., the human chromosomes 1-22) in which a trait manifests in individuals with two pathogenic alleles, either homozygotes (two copies of the same mutant allele) or compound heterozygotes (whereby each copy of a gene has a distinct mutant allele). Evidence: PCS. (PMID:26878725)
- Diffuse mesangial sclerosis (HP:0001967): Thickening and scarring (sclerosis) of the mesangium (a structure in the glomerulus). The sclerosis affects a large portion of the mesangium across multiple glomeruli. Histologic features include an increase in the mesangial matrix, thickened glomerular basement membrane, tubular casts, and interstitial inflammation. Diffuse mesangial sclerosis presents with nephrotic syndrome at birth or within the first year of life. Glomeruli are small and condensed in appearance, with early lesions showing increased loose mesangial collagen that progress to sclerosis with dense collagen without hypercellularity. Podocytes do not show hyperplasia but may be immature and cobblestone-like. Electron microscopy shows extensive foot process effacement without deposits, but increased collagen within mesangial areas. Evidence: TAS. (OMIM:616892)
- Steroid-resistant nephrotic syndrome (HP:0012588): A form of nephrotic syndrome that does not respond to treatment with steroid medication, defined as persistent proteinuria despite 60mg/m2 or 2mg/kg for 8 weeks, after insuring no infection or non-adherence to medication. Evidence: PCS. Frequency: 7/7. Onset: Childhood onset (HP:0011463). (OMIM:616892)